Phenotypes associated with the disease Glucose-galactose malabsorption (ORPHA:35710):
- Failure to thrive (HP:0001508): Failure to thrive (FTT) refers to a child whose physical growth is substantially below the norm. Evidence: TAS. Frequency: Very frequent (HP:0040281). (ORPHA:35710)
- Weight loss (HP:0001824): Reduction of total body weight. Evidence: TAS. Frequency: Very frequent (HP:0040281). (ORPHA:35710)
- Dehydration (HP:0001944). Evidence: TAS. Frequency: Very frequent (HP:0040281). (ORPHA:35710)
- Diarrhea (HP:0002014): Abnormally increased frequency (usually defined as three or more) loose or watery bowel movements a day. Evidence: TAS. Frequency: Very frequent (HP:0040281). (ORPHA:35710)
- Osmotic diarrhea (HP:0033310): Osmotic diarrhea results from the presence of osmotically active, poorly absorbed solutes in the bowel lumen that inhibit normal water and electrolyte absorption. Evidence: TAS. Frequency: Very frequent (HP:0040281). (ORPHA:35710)
- Hypernatremia (HP:0003228): The concentration of sodium in the blood circulation is above the upper limit of normal. Evidence: TAS. Frequency: Frequent (HP:0040282). (ORPHA:35710)
- Abdominal distention (HP:0003270): Distention of the abdomen. Evidence: TAS. Frequency: Frequent (HP:0040282). (ORPHA:35710)
- Malnutrition (HP:0004395): A deficiency in the intake of energy and nutrients. Evidence: TAS. Frequency: Frequent (HP:0040282). (ORPHA:35710)
- Renal insufficiency (HP:0000083): A reduction in the level of performance of the kidneys in areas of function comprising the concentration of urine, removal of wastes, the maintenance of electrolyte balance, homeostasis of blood pressure, and calcium metabolism. Evidence: TAS. Frequency: Occasional (HP:0040283). (ORPHA:35710)
- Kidney stone (HP:0000787): Kidney stones (calculi) are mineral concretions in the renal calyces and pelvis that are found free or attached to the renal papillae. Evidence: TAS. Frequency: Occasional (HP:0040283). (ORPHA:35710)
- Vomiting (HP:0002013): Forceful ejection of the contents of the stomach through the mouth by means of a series of involuntary spasmic contractions. Evidence: TAS. Frequency: Occasional (HP:0040283). (ORPHA:35710)
- Hypercalcemia (HP:0003072): The concentration of calcium in the blood circulation is above the upper limit of normal. Evidence: TAS. Frequency: Occasional (HP:0040283). (ORPHA:35710)
- Hyperactive bowel sounds (HP:0030143): Abnormally increased gurgling/rumbling sounds made by the movement of fluid and gas in the intestines. Evidence: TAS. Frequency: Occasional (HP:0040283). (ORPHA:35710)
- Hematuria (HP:0000790): The presence of blood in the urine. Hematuria may be gross hematuria (visible to the naked eye) or microscopic hematuria (detected by dipstick or microscopic examination of the urine). Evidence: TAS. Frequency: Very rare (HP:0040284). (ORPHA:35710)
- Fever (HP:0001945): Body temperature elevated above the normal range. Evidence: TAS. Frequency: Very rare (HP:0040284). (ORPHA:35710)